- Psychosis (HP:0000709): A condition characterized by changes in personality and thought patterns, often accompanied by hallucinations and delusional beliefs, is known as psychosis. Evidence: TAS. (OMIM:117300)
- Hearing impairment (HP:0000365): A decreased magnitude of the sensory perception of sound. Evidence: TAS. (OMIM:117300)
- Cerebral amyloid angiopathy (HP:0011970): Amyloid deposition in the walls of leptomeningeal and cortical arteries, arterioles, and less often capillaries and veins of the central nervous system. Evidence: PCS. (PMID:20385796)
- Dementia (HP:0000726): A loss of global cognitive ability of sufficient amount to interfere with normal social or occupational function. Dementia represents a loss of previously present cognitive abilities, generally in adults, and can affect memory, thinking, language, judgment, and behavior. Evidence: TAS. (OMIM:117300)
- Ataxia (HP:0001251): Ataxia refers to impaired coordination of voluntary muscle movement. Cerebellar ataxia refers to ataxia due to dysfunction of the cerebellum. This causes a variety of elementary neurological deficits including asynergy (lack of coordination between muscles, limbs and joints), dysmetria (lack of ability to judge distances that can lead to under- or overshoot in grasping movements), and dysdiadochokinesia (inability to perform rapid movements requiring antagonizing muscle groups to be switched on and off repeatedly). Evidence: PCS. (PMID:20385796)
- Neurofibrillary tangles (HP:0002185): Pathological protein aggregates formed by hyperphosphorylation of a microtubule-associated protein known as tau, causing it to aggregate in an insoluble form. Evidence: PCS. (PMID:11895040)
- Posterior polar cataract (HP:0001115): A polar cataract that affects the posterior pole of the lens. Evidence: TAS. (OMIM:117300)
- Intention tremor (HP:0002080): A type of kinetic tremor that occurs during target directed movement is called intention tremor. That is, an oscillatory cerebellar ataxia that tends to be absent when the limbs are inactive and during the first part of voluntary movement but worsening as the movement continues and greater precision is required (e.g., in touching a target such as the patient's nose or a physician's finger). Evidence: TAS. (OMIM:117300)
- Spasticity (HP:0001257): A motor disorder characterized by a velocity-dependent increase in tonic stretch reflexes with increased muscle tone, exaggerated (hyperexcitable) tendon reflexes. Evidence: PCS. (PMID:20385796)
- Autosomal dominant inheritance (HP:0000006): A mode of inheritance that is observed for traits related to a gene encoded on one of the autosomes (i.e., the human chromosomes 1-22) in which a trait manifests in heterozygotes. In the context of medical genetics, an autosomal dominant disorder is caused when a single copy of the mutant allele is present. Males and females are affected equally, and can both transmit the disorder with a risk of 50% for each child of inheriting the mutant allele. Evidence: TAS. (OMIM:117300)
These phenotypes are associated with the disease ADan amyloidosis (OMIM:117300).